- Typified by somatic mosaicism (HP:0001442, a Human Phenotype Ontology term): Description of conditions in which affected individuals typically display somatic mosaicism, i.e., genetically distinct populations of somatic cells in a given organism caused by DNA mutations, epigenetic alterations of DNA, chromosomal abnormalities or the spontaneous reversion of inherited mutations. In many conditions typified by somatic mosaicism, constitutive mutation is lethal and cases are exclusively or predominantly mosaic. Evidence: IEA. (OMIM:601583)
- Nephroblastoma (HP:0002667, a Human Phenotype Ontology term): The presence of a nephroblastoma, which is a neoplasm of the kidney that primarily affects children. Evidence: IEA. (OMIM:601583)
- Autosomal dominant inheritance (HP:0000006, a Human Phenotype Ontology term): A mode of inheritance that is observed for traits related to a gene encoded on one of the autosomes (i.e., the human chromosomes 1-22) in which a trait manifests in heterozygotes. In the context of medical genetics, an autosomal dominant disorder is caused when a single copy of the mutant allele is present. Males and females are affected equally, and can both transmit the disorder with a risk of 50% for each child of inheriting the mutant allele. Evidence: IEA. (OMIM:601583)
These phenotypes are associated with the disease Wilms tumor 5 (OMIM:601583, an entry in Online Mendelian Inheritance in Man).